Phenotypes associated with the disease Early infantile developmental and epileptic encephalopathy (ORPHA:1934):
- Seizure (HP:0001250): A seizure is an intermittent abnormality of nervous system physiology characterized by a transient occurrence of signs and/or symptoms due to abnormal excessive or synchronous neuronal activity in the brain. Evidence: TAS. Frequency: Obligate (HP:0040280). (ORPHA:1934)
- Intellectual disability (HP:0001249): The term intellectual disability or intellectual developmental disorder is used to describe significantly sub-average intellectual and adaptive functioning based on clinical assessment and as measured by individually administered, appropriately normed, standardized and validated tests of intellectual functioning and adaptive behavior, with onset during the developmental period from infancy through adolescence. Evidence: TAS. Frequency: Very frequent (HP:0040281). (ORPHA:1934)
- Global developmental delay (HP:0001263): A delay in the achievement of motor or mental milestones in the domains of development of a child, including motor skills, speech and language, cognitive skills, and social and emotional skills. This term should only be used to describe children younger than five years of age. Evidence: TAS. Frequency: Very frequent (HP:0040281). (ORPHA:1934)
- Generalized myoclonic seizure (HP:0002123): A generalized myoclonic seizure is a type of generalized motor seizure characterized by bilateral, sudden, brief (<100 ms) involuntary single or multiple contraction of muscles or muscle groups of variable topography (axial, proximal limb, distal). Myoclonus is less regularly repetitive and less sustained than is clonus. Evidence: TAS. Frequency: Very frequent (HP:0040281). (ORPHA:1934)
- Focal motor seizure (HP:0011153): A type of focal-onset seizure characterized by a motor sign as its initial semiological manifestation. Evidence: TAS. Frequency: Very frequent (HP:0040281). (ORPHA:1934)
- Epileptic encephalopathy (HP:0200134): A condition in which epileptiform abnormalities are believed to contribute to the progressive disturbance in cerebral function. Epileptic encephalaopathy is characterized by (1) electrographic EEG paroxysmal activity that is often aggressive, (2) seizures that are usually multiform and intractable, (3) cognitive, behavioral and neurological deficits that may be relentless, and (4) sometimes early death. Evidence: TAS. Frequency: Very frequent (HP:0040281). (ORPHA:1934)
- Lethargy (HP:0001254): A state of fatigue, either physical or mental slowness and sluggishness, with difficulties in initiating or performing simple tasks. Distinguished from apathy which implies indifference and a lack of desire or interest in the task. A person with lethargy may have the desire, but not the energy to engage in personal or socially relevant tasks. Evidence: TAS. Frequency: Frequent (HP:0040282). (ORPHA:1934)
- Hyperreflexia (HP:0001347): Hyperreflexia is the presence of hyperactive stretch reflexes of the muscles. Evidence: TAS. Frequency: Frequent (HP:0040282). (ORPHA:1934)
- Dysphagia (HP:0002015): Difficulty in swallowing. Evidence: TAS. Frequency: Frequent (HP:0040282). (ORPHA:1934)
- Poor suck (HP:0002033): An inadequate sucking reflex, resulting in the difficult of newborns to be breast-fed. Evidence: TAS. Frequency: Frequent (HP:0040282). (ORPHA:1934)
- Recurrent respiratory infections (HP:0002205): An increased susceptibility to respiratory infections as manifested by a history of recurrent respiratory infections. Evidence: TAS. Frequency: Frequent (HP:0040282). (ORPHA:1934)
- EEG abnormality (HP:0002353): Abnormality observed by electroencephalogram (EEG), which is used to record of the brain's spontaneous electrical activity from multiple electrodes placed on the scalp. Evidence: TAS. Frequency: Frequent (HP:0040282). (ORPHA:1934)
- Sleep disturbance (HP:0002360): An abnormal pattern in the quality, quantity, or characteristics of sleep. Evidence: TAS. Frequency: Frequent (HP:0040282). (ORPHA:1934)
- Poor head control (HP:0002421): Difficulty to maintain correct position of the head while standing or sitting. Infant head lag is observed when the head seems to flop around or lags posteriorly behind the trunk. Several articles have maintained that head lag should be absent by age 3 to 4 months. Evidence: TAS. Frequency: Frequent (HP:0040282). (ORPHA:1934)
- Hypsarrhythmia (HP:0002521): Hypsarrhythmia is abnormal interictal high amplitude waves and a background of irregular spikes. There is continuous (during wakefulness), high-amplitude (>200 Hz), generalized polymorphic slowing with no organized background and multifocal spikes demonstrated by electroencephalography (EEG). Evidence: TAS. Frequency: Frequent (HP:0040282). (ORPHA:1934)
- Floppy infant (HP:0008947): Floppiness/hypotonia is defined as reduced resistance to passive movement of joints. Physical examination of floppy/hypotonic infants shows head lag, lack of shoulder and elbow muscle contraction on traction response, inability to tighten the shoulder girdle muscles (or slipping through) when held under the axillae, scarf sign (when the arm is pulled to the opposite side, the arm wraps around the neck with the elbow crossing midline), hyperdorsiflexion of the feet, easy apposition of the thumb against the forearm, feet touching the cheek with ease and without discomfort, frog leg position, and inverted U sign on ventral suspension (head, arms, and legs hanging down without elbow or knee flexion and the trunk rounded in a dome shape). Evidence: TAS. Frequency: Frequent (HP:0040282). (ORPHA:1934)
- EEG with burst suppression (HP:0010851): The burst suppression pattern in electroencephalography refers to a characteristic periodic pattern of low voltage (<10 microvolts) suppressed background and a relatively shorter pattern of higher amplitude slow, sharp, and spiking complexes. Evidence: TAS. Frequency: Frequent (HP:0040282). (ORPHA:1934)
- Focal tonic seizure (HP:0011167): A type of focal motor seizure characterized by sustained increase in muscle contraction, lasting a few seconds to minutes. Evidence: TAS. Frequency: Frequent (HP:0040282). (ORPHA:1934)
- Feeding difficulties (HP:0011968): Impaired ability to eat related to problems gathering food and getting ready to suck, chew, or swallow it. Evidence: TAS. Frequency: Frequent (HP:0040282). (ORPHA:1934)
- Autistic behavior (HP:0000729): Persistent deficits in social interaction and communication and interaction as well as a markedly restricted repertoire of activity and interest as well as repetitive patterns of behavior. Evidence: TAS. Frequency: Occasional (HP:0040283). (ORPHA:1934)
- Hyperactivity (HP:0000752): Hyperactivity is a condition characterized by constant and unusually high levels of activity, even in situations where it is deemed inappropriate. Evidence: TAS. Frequency: Occasional (HP:0040283). (ORPHA:1934)
- Spasticity (HP:0001257): A motor disorder characterized by a velocity-dependent increase in tonic stretch reflexes with increased muscle tone, exaggerated (hyperexcitable) tendon reflexes. Evidence: TAS. Frequency: Occasional (HP:0040283). (ORPHA:1934)
- Choreoathetosis (HP:0001266): Involuntary movements characterized by both athetosis (inability to sustain muscles in a fixed position) and chorea (widespread jerky arrhythmic movements). Evidence: TAS. Frequency: Occasional (HP:0040283). (ORPHA:1934)
- Cerebellar atrophy (HP:0001272): Cerebellar atrophy is defined as a cerebellum with initially normal structures, in a posterior fossa with normal size, which displays enlarged fissures (interfolial spaces) in comparison to the foliae secondary to loss of tissue. Cerebellar atrophy implies irreversible loss of tissue and result from an ongoing progressive disease until a final stage is reached or a single injury, e.g. an intoxication or infectious event. Evidence: TAS. Frequency: Occasional (HP:0040283). (ORPHA:1934)
- Pachygyria (HP:0001302): Pachygyria is a malformation of cortical development with abnormally wide gyri with sulci 1,5-3 cm apart and abnormally thick cortex measuring more than 5 mm (radiological definition). See also neuropathological definitions for 2-, 3-, and 4-layered lissencephaly. Evidence: TAS. Frequency: Occasional (HP:0040283). (ORPHA:1934)
- Myoclonus (HP:0001336): Very brief, involuntary random muscular contractions occurring at rest, in response to sensory stimuli, or accompanying voluntary movements. Evidence: TAS. Frequency: Occasional (HP:0040283). (ORPHA:1934)
- Tremor (HP:0001337): An unintentional, oscillating to-and-fro muscle movement about a joint axis. Evidence: TAS. Frequency: Occasional (HP:0040283). (ORPHA:1934)
- Bilateral tonic-clonic seizure (HP:0002069): A bilateral tonic-clonic seizure is a seizure defined by a tonic (bilateral increased tone, lasting seconds to minutes) and then a clonic (bilateral sustained rhythmic jerking) phase. Evidence: TAS. Frequency: Occasional (HP:0040283). (ORPHA:1934)
- Hypoplasia of the corpus callosum (HP:0002079): Underdevelopment of the corpus callosum. Evidence: TAS. Frequency: Occasional (HP:0040283). (ORPHA:1934)
- Generalized non-motor (absence) seizure (HP:0002121): A generalized non-motor (absence) seizure is a type of a type of dialeptic seizure that is of electrographically generalized onset. It is a generalized seizure characterized by an interruption of activities, a blank stare, and usually the person will be unresponsive when spoken to. Any ictal motor phenomena are minor in comparison to these non-motor features. Evidence: TAS. Frequency: Occasional (HP:0040283). (ORPHA:1934)
- Episodic ataxia (HP:0002131): Periodic spells of incoordination and imbalance, that is, episodes of ataxia typically lasting from 10 minutes to several hours or days. Evidence: TAS. Frequency: Occasional (HP:0040283). (ORPHA:1934)
- Febrile seizure (within the age range of 3 months to 6 years) (HP:0002373): A febrile seizure is any type of seizure (most often a generalized tonic-clonic seizure) occurring with fever (at least 38 degrees Celsius) but in the absence of central nervous system infection, severe metabolic disturbance or other alternative precipitant in children between the ages of 3 months and 6 years. Evidence: TAS. Frequency: Occasional (HP:0040283). (ORPHA:1934)
- Developmental regression (HP:0002376): Loss of developmental skills, as manifested by loss of developmental milestones. Evidence: TAS. Frequency: Occasional (HP:0040283). (ORPHA:1934)
- Diffuse cerebral atrophy (HP:0002506): Diffuse unlocalised atrophy affecting the cerebrum. Evidence: TAS. Frequency: Occasional (HP:0040283). (ORPHA:1934)
- Diffuse white matter abnormalities (HP:0007204). Evidence: TAS. Frequency: Occasional (HP:0040283). (ORPHA:1934)
- Focal-onset seizure (HP:0007359): A focal-onset seizure is a type of seizure originating within networks limited to one hemisphere. They may be discretely localized or more widely distributed, and may originate in subcortical structures. Evidence: TAS. Frequency: Occasional (HP:0040283). (ORPHA:1934)
- Generalized tonic seizure (HP:0010818): A generalized tonic seizure is a type of generalized motor seizure characterized by bilateral limb stiffening or elevation, often with neck stiffening without a subsequent clonic phase. The tonic activity can be a sustained abnormal posture, either in extension or flexion, sometimes accompanied by tremor of the extremities. Evidence: TAS. Frequency: Occasional (HP:0040283). (ORPHA:1934)
- Atonic seizure (HP:0010819): Atonic seizure is a type of motor seizure characterized by a sudden loss or diminution of muscle tone without apparent preceding myoclonic or tonic event lasting about 1 to 2 seconds, involving head, trunk, jaw, or limb musculature. Evidence: TAS. Frequency: Occasional (HP:0040283). (ORPHA:1934)
- EEG with spike-wave complexes (HP:0010850): Complexes of spikes (<70 ms) and sharp waves (70-200 ms), which are sharp transient waves that have a strong association with epilepsy, in cerebral electrical activity recorded along the scalp by electroencephalography (EEG). Evidence: TAS. Frequency: Occasional (HP:0040283). (ORPHA:1934)
- Generalized clonic seizure (HP:0011169): Generalized clonic seizure is a type of generalized motor seizure characterized by sustained bilateral jerking, either symmetric or asymmetric, that is regularly repetitive and involves the same muscle groups. Evidence: TAS. Frequency: Occasional (HP:0040283). (ORPHA:1934)
- Uni- and bilateral multifocal epileptiform discharges (HP:0011190): Epileptiform discharges identified at multiple locations temporarily in both hemispheres and temporarily in one hemisphere. Evidence: TAS. Frequency: Occasional (HP:0040283). (ORPHA:1934)
- Delayed myelination (HP:0012448): Delayed myelination. Evidence: TAS. Frequency: Occasional (HP:0040283). (ORPHA:1934)
- Infantile spasms (HP:0012469): Infantile spasms represent a subset of "epileptic spasms". Infantile Spasms are epileptic spasms starting in the first year of life (infancy). Evidence: TAS. Frequency: Occasional (HP:0040283). (ORPHA:1934)
- Dyskinesia (HP:0100660): A movement disorder which consists of effects including diminished voluntary movements and the presence of involuntary movements. Evidence: TAS. Frequency: Occasional (HP:0040283). (ORPHA:1934)
- Self-injurious behavior (HP:0100716): Self-aggression. Evidence: TAS. Frequency: Occasional (HP:0040283). (ORPHA:1934)
- Micropenis (HP:0000054): Abnormally small penis. At birth, the normal penis is about 3 cm (stretched length from pubic tubercle to tip of penis) with micropenis less than 2.0-2.5 cm. Evidence: TAS. Frequency: Very rare (HP:0040284). (ORPHA:1934)
- Ureterocele (HP:0000070): A ureterocele is a congenital saccular dilatation of the distal segment of the ureter. Evidence: TAS. Frequency: Very rare (HP:0040284). (ORPHA:1934)
- Renal dysplasia (HP:0000110): The presence of developmental dysplasia of the kidney. Evidence: TAS. Frequency: Very rare (HP:0040284). (ORPHA:1934)
- Cleft palate (HP:0000175): Cleft palate is a developmental defect of the palate resulting from a failure of fusion of the palatine processes and manifesting as a separation of the roof of the mouth (soft and hard palate). Evidence: TAS. Frequency: Very rare (HP:0040284). (ORPHA:1934)
- Microcephaly (HP:0000252): Head circumference below 2 standard deviations below the mean for age and gender. Evidence: TAS. Frequency: Very rare (HP:0040284). (ORPHA:1934)
- Sloping forehead (HP:0000340): Inclination of the anterior surface of the forehead from the vertical more than two standard deviations above the mean (objective); or apparently excessive posterior sloping of the forehead in a lateral view. Evidence: TAS. Frequency: Very rare (HP:0040284). (ORPHA:1934)
- Anteverted nares (HP:0000463): Anteriorly-facing nostrils viewed with the head in the Frankfurt horizontal and the eyes of the observer level with the eyes of the subject. This gives the appearance of an upturned nose (upturned nasal tip). Evidence: TAS. Frequency: Very rare (HP:0040284). (ORPHA:1934)
- Strabismus (HP:0000486): A misalignment of the eyes so that the visual axes deviate from bifoveal fixation. The classification of strabismus may be based on a number of features including the relative position of the eyes, whether the deviation is latent or manifest, intermittent or constant, concomitant or otherwise and according to the age of onset and the relevance of any associated refractive error. Evidence: TAS. Frequency: Very rare (HP:0040284). (ORPHA:1934)
- Precocious puberty (HP:0000826): The onset of secondary sexual characteristics before a normal age. Although it is difficult to define normal age ranges because of the marked variation with which puberty begins in normal children, precocious puberty can be defined as the onset of puberty before the age of 8 years in girls or 9 years in boys. Evidence: TAS. Frequency: Very rare (HP:0040284). (ORPHA:1934)
- Dystonia (HP:0001332): An abnormally increased muscular tone that causes fixed abnormal postures. There is a slow, intermittent twisting motion that leads to exaggerated turning and posture of the extremities and trunk. Evidence: TAS. Frequency: Very rare (HP:0040284). (ORPHA:1934)
- Broad finger (HP:0001500): Increased width of a non-thumb digit of the hand. Evidence: TAS. Frequency: Very rare (HP:0040284). (ORPHA:1934)
- Failure to thrive (HP:0001508): Failure to thrive (FTT) refers to a child whose physical growth is substantially below the norm. Evidence: TAS. Frequency: Very rare (HP:0040284). (ORPHA:1934)
- Umbilical hernia (HP:0001537): Protrusion of abdominal contents through a defect in the abdominal wall musculature around the umbilicus. Skin and subcutaneous tissue overlie the defect. Evidence: TAS. Frequency: Very rare (HP:0040284). (ORPHA:1934)
- Ventricular septal defect (HP:0001629): A hole between the two bottom chambers (ventricles) of the heart. The defect is centered around the most superior aspect of the ventricular septum. Evidence: TAS. Frequency: Very rare (HP:0040284). (ORPHA:1934)
- Depressed nasal bridge (HP:0005280): Posterior positioning of the nasal root in relation to the overall facial profile for age. Evidence: TAS. Frequency: Very rare (HP:0040284). (ORPHA:1934)
- Short finger (HP:0009381): Abnormally short finger associated with developmental hypoplasia. Evidence: TAS. Frequency: Very rare (HP:0040284). (ORPHA:1934)
- Broad phalanx of the toes (HP:0010174): Increased width of phalanx of one or more toes. Evidence: TAS. Frequency: Very rare (HP:0040284). (ORPHA:1934)
- Absent thumbnail (HP:0012554): Absence of thumb nail. Evidence: TAS. Frequency: Very rare (HP:0040284). (ORPHA:1934)